- Fever (HP:0001945): Body temperature elevated above the normal range. Evidence: TAS. Frequency: Very frequent (HP:0040281). (ORPHA:50839)
- Lymphadenopathy (HP:0002716): Enlargement (swelling) of a lymph node. Evidence: TAS. Frequency: Very frequent (HP:0040281). (ORPHA:50839)
- Erythematous papule (HP:0030350): A circumscribed, solid elevation of skin with no visible fluid that is reddish (erythematous) in color. Evidence: TAS. Frequency: Very frequent (HP:0040281). (ORPHA:50839)
- Anorexia (HP:0002039): Lack of desire to eat (loss of appetite). Evidence: TAS. Frequency: Frequent (HP:0040282). (ORPHA:50839)
- Malaise (HP:0033834): A feeling of general discomfort, weakness, or lack of health. Evidence: TAS. Frequency: Frequent (HP:0040282). (ORPHA:50839)
- Retinal detachment (HP:0000541): Separation of the inner layers of the retina (neural retina) from the pigment epithelium. Evidence: TAS. Frequency: Occasional (HP:0040283). (ORPHA:50839)
- Arthritis (HP:0001369): Inflammation of a joint. Evidence: TAS. Frequency: Occasional (HP:0040283). (ORPHA:50839)
- Hepatosplenomegaly (HP:0001433): Simultaneous enlargement of the liver and spleen. Evidence: TAS. Frequency: Occasional (HP:0040283). (ORPHA:50839)
- Weight loss (HP:0001824): Reduction of total body weight. Evidence: TAS. Frequency: Occasional (HP:0040283). (ORPHA:50839)
- Abdominal pain (HP:0002027): An unpleasant sensation characterized by physical discomfort (such as pricking, throbbing, or aching) and perceived to originate in the abdomen. Evidence: TAS. Frequency: Occasional (HP:0040283). (ORPHA:50839)
- Arthralgia (HP:0002829): Joint pain. Evidence: TAS. Frequency: Occasional (HP:0040283). (ORPHA:50839)
- Myalgia (HP:0003326): Pain in muscle. Evidence: TAS. Frequency: Occasional (HP:0040283). (ORPHA:50839)
- Elevated erythrocyte sedimentation rate (HP:0003565): An increased erythrocyte sedimentation rate (ESR). The ESR is a test that measures the distance that erythrocytes have fallen after one hour in a vertical column of anticoagulated blood under the influence of gravity. The ESR is a nonspecific finding. An elevation may indicate inflammation or may be caused by any condition that elevates fibrinogen. Evidence: TAS. Frequency: Occasional (HP:0040283). (ORPHA:50839)
- Elevated circulating C-reactive protein concentration (HP:0011227): The concentration of C-reactive protein in the blood circulation is above the upper limit of normal. Evidence: TAS. Frequency: Occasional (HP:0040283). (ORPHA:50839)
- Panuveitis (HP:0012121): Inflammation of the uveal tract in which inflammation affects the anterior chamber, vitreous, retina or choroid. Evidence: TAS. Frequency: Occasional (HP:0040283). (ORPHA:50839)
- Branch retinal artery occlusion (HP:0020161): Blockage of a branch of the retinal artery. This can cause loss of a section of visual field. Evidence: TAS. Frequency: Occasional (HP:0040283). (ORPHA:50839)
- Branch retinal vein occlusion (HP:0020165): Blockage of a branch of the retinal vein. It may present with sudden-onset of painless vision loss or visual field defect correlating to the area of perfusion of the obstructed vessels. Evidence: TAS. Frequency: Occasional (HP:0040283). (ORPHA:50839)
- Retinitis (HP:0032118): Inflammation of the retina of the eye. Evidence: TAS. Frequency: Occasional (HP:0040283). (ORPHA:50839)
- Optic neuritis (HP:0100653): Inflammation of the optic nerve. Evidence: TAS. Frequency: Occasional (HP:0040283). (ORPHA:50839)
- Osteomyelitis (HP:0002754): Osteomyelitis is an inflammatory process accompanied by bone destruction and caused by an infecting microorganism. Evidence: TAS. Frequency: Very rare (HP:0040284). (ORPHA:50839)
- Non-infectious meningitis (HP:0033430): Inflammation of the layers of tissue that cover the brain and spinal cord (meninges) and of the fluid-filled space between the meninges (subarachnoid space) when it is caused by disorders that are not infections or by drugs or vaccines. Evidence: TAS. Frequency: Very rare (HP:0040284). (ORPHA:50839)
- Endocarditis (HP:0100584): An inflammation of the endocardium, the inner layer of the heart, which usually involves the heart valves. Evidence: TAS. Frequency: Very rare (HP:0040284). (ORPHA:50839)
These phenotypes are associated with the disease Cat-scratch disease (ORPHA:50839).